- Chorioretinal dysplasia (HP:0007731): Abnormal development of the choroid and retina. Evidence: TAS. Frequency: Occasional (HP:0040283). (ORPHA:2526)
- Retinal dysplasia (HP:0007973): Abnormal growth and differentiation, structure and appearance of the retina present from birth. Evidence: TAS. Frequency: Occasional (HP:0040283). (ORPHA:2526)
- Underdeveloped supraorbital ridges (HP:0009891): Flatness of the supraorbital portion of the frontal bones. Evidence: TAS. Frequency: Occasional (HP:0040283). (ORPHA:2526)
- Chylothorax (HP:0010310): Accumulation of excessive amounts of lymphatic fluid (chyle) in the pleural cavity. Evidence: TAS. Frequency: Occasional (HP:0040283). (ORPHA:2526)
- Thick vermilion border (HP:0012471): Increased width of the skin of vermilion border region of upper lip. Evidence: TAS. Frequency: Occasional (HP:0040283). (ORPHA:2526)
- Panniculitis (HP:0012490): Inflammation of subcutaneous adipose tissue. Evidence: TAS. Frequency: Occasional (HP:0040283). (ORPHA:2526)
- Scaling skin (HP:0040189): Refers to the loss of the outer layer of the epidermis in large, scale-like flakes. Evidence: TAS. Frequency: Occasional (HP:0040283). (ORPHA:2526)
- Cellulitis (HP:0100658): A bacterial infection and inflammation of the skin und subcutaneous tissues. Evidence: TAS. Frequency: Occasional (HP:0040283). (ORPHA:2526)
- Gangrene (HP:0100758): A serious and potentially life-threatening condition that arises when a considerable mass of body tissue dies (necrosis). Evidence: TAS. Frequency: Occasional (HP:0040283). (ORPHA:2526)
- Skin ulcer (HP:0200042): A discontinuity of the skin exhibiting complete loss of the epidermis and often portions of the dermis and even subcutaneous fat. Evidence: TAS. Frequency: Occasional (HP:0040283). (ORPHA:2526)
- Microcephaly (HP:0000252): Head circumference below 2 standard deviations below the mean for age and gender. Evidence: TAS. Frequency: Very frequent (HP:0040281). (ORPHA:2526)
- Abnormality of the eye (HP:0000478): Any abnormality of the eye, including location, spacing, and intraocular abnormalities. Evidence: TAS. Frequency: Very frequent (HP:0040281). (ORPHA:2526)
- Abnormality of vision (HP:0000504): Abnormality of eyesight (visual perception). Evidence: TAS. Frequency: Very frequent (HP:0040281). (ORPHA:2526)
- Lymphedema (HP:0001004): Localized fluid retention and tissue swelling caused by a compromised lymphatic system. Evidence: TAS. Frequency: Very frequent (HP:0040281). (ORPHA:2526)
- Myopia (HP:0000545): An abnormality of refraction characterized by the ability to see objects nearby clearly, while objects in the distance appear blurry. Evidence: TAS. Frequency: Frequent (HP:0040282). (ORPHA:2526)
- Edema (HP:0000969): An abnormal accumulation of fluid beneath the skin, or in one or more cavities of the body. Evidence: TAS. Frequency: Frequent (HP:0040282). (ORPHA:2526)
- Intellectual disability (HP:0001249): The term intellectual disability or intellectual developmental disorder is used to describe significantly sub-average intellectual and adaptive functioning based on clinical assessment and as measured by individually administered, appropriately normed, standardized and validated tests of intellectual functioning and adaptive behavior, with onset during the developmental period from infancy through adolescence. Evidence: TAS. Frequency: Frequent (HP:0040282). (ORPHA:2526)
- Hypotonia (HP:0001252): Hypotonia is an abnormally low muscle tone (the amount of tension or resistance to movement in a muscle). Even when relaxed, muscles have a continuous and passive partial contraction which provides some resistance to passive stretching. Hypotonia thus manifests as diminished resistance to passive stretching. Hypotonia is not the same as muscle weakness, although the two conditions can co-exist. Evidence: TAS. Frequency: Frequent (HP:0040282). (ORPHA:2526)
- Global developmental delay (HP:0001263): A delay in the achievement of motor or mental milestones in the domains of development of a child, including motor skills, speech and language, cognitive skills, and social and emotional skills. This term should only be used to describe children younger than five years of age. Evidence: TAS. Frequency: Frequent (HP:0040282). (ORPHA:2526)
- Specific learning disability (HP:0001328): Impairment of certain skills such as reading or writing, coordination, self-control, or attention that interfere with the ability to learn. The impairment is not related to a global deficiency of intelligence. Evidence: TAS. Frequency: Frequent (HP:0040282). (ORPHA:2526)
- Abnormal hair morphology (HP:0001595): An abnormality of the hair. Evidence: TAS. Frequency: Frequent (HP:0040282). (ORPHA:2526)
- Leukonychia (HP:0001820): White discoloration of the nails. Evidence: TAS. Frequency: Frequent (HP:0040282). (ORPHA:2526)
- Abnormal retinal pigmentation (HP:0007703): Any deviation from the normal pigmentation of the retina. Evidence: TAS. Frequency: Frequent (HP:0040282). (ORPHA:2526)
- Abnormal toenail morphology (HP:0008388): An anomaly of the toenail. Evidence: TAS. Frequency: Frequent (HP:0040282). (ORPHA:2526)
- Melanonychia (HP:0100644): Dark discoloration of a fingernail or toenail (brown, black, bluish and reddish). Evidence: TAS. Frequency: Frequent (HP:0040282). (ORPHA:2526)
- Epicanthus (HP:0000286): A fold of skin starting above the medial aspect of the upper eyelid and arching downward to cover, pass in front of and lateral to the medial canthus. Evidence: TAS. Frequency: Occasional (HP:0040283). (ORPHA:2526)
- Full cheeks (HP:0000293): Increased prominence or roundness of soft tissues between zygomata and mandible. Evidence: TAS. Frequency: Occasional (HP:0040283). (ORPHA:2526)
- Pointed chin (HP:0000307): A marked tapering of the lower face to the chin. Evidence: TAS. Frequency: Occasional (HP:0040283). (ORPHA:2526)
- Sloping forehead (HP:0000340): Inclination of the anterior surface of the forehead from the vertical more than two standard deviations above the mean (objective); or apparently excessive posterior sloping of the forehead in a lateral view. Evidence: TAS. Frequency: Occasional (HP:0040283). (ORPHA:2526)
- Long philtrum (HP:0000343): Distance between nasal base and midline upper lip vermilion border more than 2 SD above the mean. Alternatively, an apparently increased distance between nasal base and midline upper lip vermilion border. Evidence: TAS. Frequency: Occasional (HP:0040283). (ORPHA:2526)
- Protruding ear (HP:0000411): Angle formed by the plane of the ear and the mastoid bone greater than the 97th centile for age (objective); or, outer edge of the helix more than 2 cm from the mastoid at the point of maximum distance (objective). Evidence: TAS. Frequency: Occasional (HP:0040283). (ORPHA:2526)
- Wide nasal bridge (HP:0000431): Increased breadth of the nasal bridge (and with it, the nasal root). Evidence: TAS. Frequency: Occasional (HP:0040283). (ORPHA:2526)
- Wide nose (HP:0000445): Interalar distance more than two standard deviations above the mean for age, i.e., an apparently increased width of the nasal base and alae. Evidence: TAS. Frequency: Occasional (HP:0040283). (ORPHA:2526)
- Anteverted nares (HP:0000463): Anteriorly-facing nostrils viewed with the head in the Frankfurt horizontal and the eyes of the observer level with the eyes of the subject. This gives the appearance of an upturned nose (upturned nasal tip). Evidence: TAS. Frequency: Occasional (HP:0040283). (ORPHA:2526)
- Retinopathy (HP:0000488): Any noninflammatory disease of the retina. This nonspecific term is retained here because of its wide use in the literature, but if possible new annotations should indicate the precise type of retinal abnormality. Evidence: TAS. Frequency: Occasional (HP:0040283). (ORPHA:2526)
- Abnormal eyelid morphology (HP:0000492): An abnormality of the eyelids. Evidence: TAS. Frequency: Occasional (HP:0040283). (ORPHA:2526)
- Abnormal eyelash morphology (HP:0000499): An abnormality of the eyelashes. Evidence: TAS. Frequency: Occasional (HP:0040283). (ORPHA:2526)
- Glaucoma (HP:0000501): Glaucoma refers loss of retinal ganglion cells in a characteristic pattern of optic neuropathy usually associated with increased intraocular pressure. Evidence: TAS. Frequency: Occasional (HP:0040283). (ORPHA:2526)
- Ptosis (HP:0000508): The upper eyelid margin is positioned 3 mm or more lower than usual and covers the superior portion of the iris (objective); or, the upper lid margin obscures at least part of the pupil (subjective). Evidence: TAS. Frequency: Occasional (HP:0040283). (ORPHA:2526)
- Cataract (HP:0000518): A cataract is an opacity or clouding that develops in the crystalline lens of the eye or in its capsule. Evidence: TAS. Frequency: Occasional (HP:0040283). (ORPHA:2526)
- Anophthalmia (HP:0000528): Absence of the globe or eyeball. Evidence: TAS. Frequency: Occasional (HP:0040283). (ORPHA:2526)
- Retinal detachment (HP:0000541): Separation of the inner layers of the retina (neural retina) from the pigment epithelium. Evidence: TAS. Frequency: Occasional (HP:0040283). (ORPHA:2526)
- Retinal dystrophy (HP:0000556): Retinal dystrophy is an abnormality of the retina associated with a hereditary process. Retinal dystrophies are defined by their predominantly monogenic inheritance and they are frequently associated with loss or dysfunction of photoreceptor cells as a primary or secondary event. Evidence: TAS. Frequency: Occasional (HP:0040283). (ORPHA:2526)
- Microphthalmia (HP:0000568): A developmental anomaly characterized by abnormal smallness of one or both eyes. Evidence: TAS. Frequency: Occasional (HP:0040283). (ORPHA:2526)
- Visual loss (HP:0000572): Loss of visual acuity (implying that vision was better at a certain time point in life). Otherwise the term reduced visual acuity should be used (or a subclass of that). Evidence: TAS. Frequency: Occasional (HP:0040283). (ORPHA:2526)
- Upslanted palpebral fissure (HP:0000582): The palpebral fissure inclination is more than two standard deviations above the mean for age (objective); or, the inclination of the palpebral fissure is greater than typical for age. Evidence: TAS. Frequency: Occasional (HP:0040283). (ORPHA:2526)
- Abnormal optic nerve morphology (HP:0000587): Abnormality of the optic nerve. Evidence: TAS. Frequency: Occasional (HP:0040283). (ORPHA:2526)
- Abnormal nasolacrimal system morphology (HP:0000614): An abnormality of the nasolacrimal drainage system, which serves as a conduit for tear flow from the external eye to the nasal cavity. Evidence: TAS. Frequency: Occasional (HP:0040283). (ORPHA:2526)
- Blindness (HP:0000618): Blindness is the condition of lacking visual perception defined as a profound reduction in visual perception. On the 6m visual acuity scale, blindness is defined as less than 3/60. On the 20ft visual acuity scale, blindness is defined as less than 20/400. On the decimal visual acuity scale, blindness is defined as less than 0.05. Blindness is typically characterized by a visual field of no greater than 10 degrees in radius around central fixation. Evidence: TAS. Frequency: Occasional (HP:0040283). (ORPHA:2526)
- Amblyopia (HP:0000646): Reduced visual acuity that is uncorrectable by lenses in the absence of detectable anatomic defects in the eye or visual pathways. Evidence: TAS. Frequency: Occasional (HP:0040283). (ORPHA:2526)
- Optic atrophy (HP:0000648): Atrophy of the optic nerve. Optic atrophy results from the death of the retinal ganglion cell axons that comprise the optic nerve and manifesting as a pale optic nerve on fundoscopy. Evidence: TAS. Frequency: Occasional (HP:0040283). (ORPHA:2526)
- Dry skin (HP:0000958): Skin characterized by the lack of natural or normal moisture. Evidence: TAS. Frequency: Occasional (HP:0040283). (ORPHA:2526)
- Erysipelas (HP:0001055): Increased susceptibility to erysipelas, as manifested by a medical history of repeated episodes of erysipelas, which is a superficial infection of the skin, typically involving the lymphatic system. Evidence: TAS. Frequency: Occasional (HP:0040283). (ORPHA:2526)
- Thickened skin (HP:0001072): Laminar thickening of skin. Evidence: TAS. Frequency: Occasional (HP:0040283). (ORPHA:2526)
- Seizure (HP:0001250): A seizure is an intermittent abnormality of nervous system physiology characterized by a transient occurrence of signs and/or symptoms due to abnormal excessive or synchronous neuronal activity in the brain. Evidence: TAS. Frequency: Occasional (HP:0040283). (ORPHA:2526)
- Spasticity (HP:0001257): A motor disorder characterized by a velocity-dependent increase in tonic stretch reflexes with increased muscle tone, exaggerated (hyperexcitable) tendon reflexes. Evidence: TAS. Frequency: Occasional (HP:0040283). (ORPHA:2526)
- Hypertonia (HP:0001276): A condition in which there is increased muscle tone so that arms or legs, for example, are stiff and difficult to move. Evidence: TAS. Frequency: Occasional (HP:0040283). (ORPHA:2526)
- Subcutaneous nodule (HP:0001482): Slightly elevated lesions on or in the skin with a diameter of over 5 mm. Evidence: TAS. Frequency: Occasional (HP:0040283). (ORPHA:2526)
- Atrial septal defect (HP:0001631): Atrial septal defect (ASD) is a congenital abnormality of the interatrial septum that enables blood flow between the left and right atria via the interatrial septum. Evidence: TAS. Frequency: Occasional (HP:0040283). (ORPHA:2526)
- Leukemia (HP:0001909): A cancer of the blood and bone marrow characterized by an abnormal proliferation of leukocytes. Evidence: TAS. Frequency: Occasional (HP:0040283). (ORPHA:2526)
- Rigidity (HP:0002063): Continuous involuntary sustained muscle contraction. When an affected muscle is passively stretched, the degree of resistance remains constant regardless of the rate at which the muscle is stretched. This feature helps to distinguish rigidity from muscle spasticity. Evidence: TAS. Frequency: Occasional (HP:0040283). (ORPHA:2526)
- Status epilepticus (HP:0002133): Status epilepticus is a type of prolonged seizure resulting either from the failure of the mechanisms responsible for seizure termination or from the initiation of mechanisms which lead to abnormally prolonged seizures (after time point t1). It is a condition that can have long-term consequences (after time point t2), including neuronal death, neuronal injury, and alteration of neuronal networks, depending on the type and duration of seizures. Evidence: TAS. Frequency: Occasional (HP:0040283). (ORPHA:2526)
- Pleural effusion (HP:0002202): The presence of an excessive amount of fluid in the pleural cavity. Evidence: TAS. Frequency: Occasional (HP:0040283). (ORPHA:2526)
- Lymphoma (HP:0002665): A cancer originating in lymphocytes and presenting as a solid tumor of lymhpoid cells. Evidence: TAS. Frequency: Occasional (HP:0040283). (ORPHA:2526)
- Severe short stature (HP:0003510): A severe degree of short stature, more than -4 SD from the mean corrected for age and sex. Evidence: TAS. Frequency: Occasional (HP:0040283). (ORPHA:2526)
- Muscle stiffness (HP:0003552): A condition in which muscles cannot be moved quickly without accompanying pain or spasm. Evidence: TAS. Frequency: Occasional (HP:0040283). (ORPHA:2526)
- Venous thrombosis (HP:0004936): Formation of a blood clot (thrombus) inside a vein, causing the obstruction of blood flow. Evidence: TAS. Frequency: Occasional (HP:0040283). (ORPHA:2526)
These phenotypes are associated with the disease Microcephaly-lymphedema-chorioretinopathy syndrome (ORPHA:2526).